- Inguinal hernia (HP:0000023): Protrusion of the contents of the abdominal cavity through the inguinal canal. Evidence: TAS. Frequency: Occasional (HP:0040283). (ORPHA:7)
- Hypospadias (HP:0000047): Abnormal position of urethral meatus on the ventral penile shaft (underside) characterized by displacement of the urethral meatus from the tip of the glans penis to the ventral surface of the penis, scrotum, or perineum. Evidence: TAS. Frequency: Occasional (HP:0040283). (ORPHA:7)
- Hydronephrosis (HP:0000126): Severe distention of the kidney with dilation of the renal pelvis and calices. Evidence: TAS. Frequency: Occasional (HP:0040283). (ORPHA:7)
- Cleft palate (HP:0000175): Cleft palate is a developmental defect of the palate resulting from a failure of fusion of the palatine processes and manifesting as a separation of the roof of the mouth (soft and hard palate). Evidence: TAS. Frequency: Frequent (HP:0040282). (ORPHA:7)
- Orofacial cleft (HP:0000202): The presence of a cleft (gap, opening, or groove) in the oral cavity, including cleft of the upper lip and/or cleft of the palate. Cleft of the upper lip is visible as a groove or fissure in the lip, most frequently due to a congenital failure of the maxillary and median nasal processes to fuse. Cleft palate is characterized by a grooved depression or fissure in the roof of the mouth, most often resulting from a congenital failure of the palate to fuse properly. Clefts of the lip and palate can occur individually or together. It is preferable to code each defect separately. Evidence: TAS. Frequency: Occasional (HP:0040283). (ORPHA:7)
- Abnormal cranial suture/fontanelle morphology (HP:0000235): Any abnormality of the fontanelles (the regions covered by a thick membrane that normally ossify in the first two years of life) or the cranial sutures (the fibrous joints in which the articulating bones or cartilages of the skull are connected by sutural ligaments). Evidence: TAS. Frequency: Very frequent (HP:0040281). (ORPHA:7)
- Hydrocephalus (HP:0000238): Hydrocephalus is an active distension of the ventricular system of the brain resulting from inadequate passage of CSF from its point of production within the cerebral ventricles to its point of absorption into the systemic circulation. Evidence: TAS. Frequency: Frequent (HP:0040282). (ORPHA:7)
- Macrocephaly (HP:0000256): Occipitofrontal (head) circumference greater than 97th centile compared to appropriate, age matched, sex-matched normal standards. Alternatively, a apparently increased size of the cranium. Evidence: TAS. Frequency: Frequent (HP:0040282). (ORPHA:7)
- Prominent occiput (HP:0000269): Increased convexity of the occiput (posterior part of the skull). Evidence: TAS. Frequency: Frequent (HP:0040282). (ORPHA:7)
- Hypertelorism (HP:0000316): Interpupillary distance more than 2 SD above the mean (alternatively, the appearance of an increased interpupillary distance or widely spaced eyes). Evidence: TAS. Frequency: Very frequent (HP:0040281). (ORPHA:7)
- Facial hemangioma (HP:0000329): Hemangioma, a benign tumor of the vascular endothelial cells, occurring in the face. Evidence: TAS. Frequency: Occasional (HP:0040283). (ORPHA:7)
- Micrognathia (HP:0000347): Developmental hypoplasia of the mandible. Evidence: TAS. Frequency: Occasional (HP:0040283). (ORPHA:7)
- Low-set ears (HP:0000369): Upper insertion of the ear to the scalp below an imaginary horizontal line drawn between the inner canthi of the eye and extending posteriorly to the ear. Evidence: TAS. Frequency: Frequent (HP:0040282). (ORPHA:7)
- Preauricular skin tag (HP:0000384): A rudimentary tag of skin often containing ear tissue including a core of cartilage and located just anterior to the auricle (outer part of the ear). Evidence: TAS. Frequency: Occasional (HP:0040283). (ORPHA:7)
- Wide nasal bridge (HP:0000431): Increased breadth of the nasal bridge (and with it, the nasal root). Evidence: TAS. Frequency: Very frequent (HP:0040281). (ORPHA:7)
- Short neck (HP:0000470): Diminished length of the neck. Evidence: TAS. Frequency: Occasional (HP:0040283). (ORPHA:7)
- Downslanted palpebral fissures (HP:0000494): The palpebral fissure inclination is more than two standard deviations below the mean. Evidence: TAS. Frequency: Frequent (HP:0040282). (ORPHA:7)
- Glaucoma (HP:0000501): Glaucoma refers loss of retinal ganglion cells in a characteristic pattern of optic neuropathy usually associated with increased intraocular pressure. Evidence: TAS. Frequency: Occasional (HP:0040283). (ORPHA:7)
- Chorioretinal coloboma (HP:0000567): Absence of a region of the retina, retinal pigment epithelium, and choroid. Evidence: TAS. Frequency: Occasional (HP:0040283). (ORPHA:7)
- Iris coloboma (HP:0000612): A coloboma of the iris. Evidence: TAS. Frequency: Occasional (HP:0040283). (ORPHA:7)
- Optic atrophy (HP:0000648): Atrophy of the optic nerve. Optic atrophy results from the death of the retinal ganglion cell axons that comprise the optic nerve and manifesting as a pale optic nerve on fundoscopy. Evidence: TAS. Frequency: Occasional (HP:0040283). (ORPHA:7)
- Adrenal hypoplasia (HP:0000835): Developmental hypoplasia of the adrenal glands. Evidence: TAS. Frequency: Occasional (HP:0040283). (ORPHA:7)
- Missing ribs (HP:0000921): A developmental anomaly with absence of one or more ribs. Evidence: TAS. Frequency: Occasional (HP:0040283). (ORPHA:7)
- Brachydactyly (HP:0001156): Digits that appear disproportionately short compared to the hand/foot. The word brachydactyly is used here to describe a series distinct patterns of shortened digits (brachydactyly types A-E). This is the sense used here. Evidence: TAS. Frequency: Occasional (HP:0040283). (ORPHA:7)
- Hand polydactyly (HP:0001161): A kind of polydactyly characterized by the presence of a supernumerary finger or fingers. Evidence: TAS. Frequency: Occasional (HP:0040283). (ORPHA:7)
- Single umbilical artery (HP:0001195): Single umbilical artery (SUA) is the absence of one of the two umbilical arteries surrounding the fetal bladder and in the fetal umbilical cord. Evidence: TAS. Frequency: Occasional (HP:0040283). (ORPHA:7)
- Intellectual disability (HP:0001249): The term intellectual disability or intellectual developmental disorder is used to describe significantly sub-average intellectual and adaptive functioning based on clinical assessment and as measured by individually administered, appropriately normed, standardized and validated tests of intellectual functioning and adaptive behavior, with onset during the developmental period from infancy through adolescence. Evidence: TAS. Frequency: Very frequent (HP:0040281). (ORPHA:7)
- Hypotonia (HP:0001252): Hypotonia is an abnormally low muscle tone (the amount of tension or resistance to movement in a muscle). Even when relaxed, muscles have a continuous and passive partial contraction which provides some resistance to passive stretching. Hypotonia thus manifests as diminished resistance to passive stretching. Hypotonia is not the same as muscle weakness, although the two conditions can co-exist. Evidence: TAS. Frequency: Very frequent (HP:0040281). (ORPHA:7)
- Global developmental delay (HP:0001263): A delay in the achievement of motor or mental milestones in the domains of development of a child, including motor skills, speech and language, cognitive skills, and social and emotional skills. This term should only be used to describe children younger than five years of age. Evidence: TAS. Frequency: Very frequent (HP:0040281). (ORPHA:7)
- Dandy-Walker malformation (HP:0001305): A congenital brain malformation typically characterized by incomplete formation of the cerebellar vermis, dilation of the fourth ventricle, and enlargement of the posterior fossa. In layman's terms, Dandy Walker malformation is a cyst in the cerebellum (typically symmetrical) that is involved with the fourth ventricle. This may interfere with the ability to drain cerebrospinal fluid from the brain, resulting in hydrocephalus. Dandy Walker cysts are formed during early embryonic development, while the brain forms. The cyst in the cerebellum typically has several blood vessels running through it connecting to the brain, thereby prohibiting surgical removal. Evidence: TAS. Frequency: Very frequent (HP:0040281). (ORPHA:7)
- Death in infancy (HP:0001522): Death within the first 24 months of life. Evidence: TAS. Frequency: Frequent (HP:0040282). (ORPHA:7)
- Ventricular septal defect (HP:0001629): A hole between the two bottom chambers (ventricles) of the heart. The defect is centered around the most superior aspect of the ventricular septum. Evidence: TAS. Frequency: Frequent (HP:0040282). (ORPHA:7)
- Atrial septal defect (HP:0001631): Atrial septal defect (ASD) is a congenital abnormality of the interatrial septum that enables blood flow between the left and right atria via the interatrial septum. Evidence: TAS. Frequency: Frequent (HP:0040282). (ORPHA:7)
- Abnormal mitral valve morphology (HP:0001633): Any structural anomaly of the mitral valve. Evidence: TAS. Frequency: Frequent (HP:0040282). (ORPHA:7)
- Tetralogy of Fallot (HP:0001636): A congenital cardiac malformation comprising pulmonary stenosis, overriding aorta, ventricular septum defect, and right ventricular hypertrophy. The diagnosis of TOF is made if at least three of the four above mentioned features are present. Evidence: TAS. Frequency: Frequent (HP:0040282). (ORPHA:7)
- Pulmonic stenosis (HP:0001642): A narrowing of the right ventricular outflow tract that can occur at the pulmonary valve (valvular stenosis), below the pulmonary valve (infundibular stenosis), or above the pulmonary valve (supravalvar stenosis). Evidence: TAS. Frequency: Frequent (HP:0040282). (ORPHA:7)
- Aortic valve stenosis (HP:0001650): The presence of a stenosis (narrowing) of the aortic valve. Evidence: TAS. Frequency: Frequent (HP:0040282). (ORPHA:7)
- Abnormal tricuspid valve morphology (HP:0001702): Any structural anomaly of the tricuspid valve. Evidence: TAS. Frequency: Frequent (HP:0040282). (ORPHA:7)
- Hypoplastic fingernail (HP:0001804): Underdevelopment of a fingernail. Evidence: TAS. Frequency: Occasional (HP:0040283). (ORPHA:7)
- Frontal bossing (HP:0002007): Bilateral bulging of the lateral frontal bone prominences with relative sparing of the midline. Evidence: TAS. Frequency: Very frequent (HP:0040281). (ORPHA:7)
- Gastroesophageal reflux (HP:0002020): A condition in which the stomach contents leak backwards from the stomach into the esophagus through the lower esophageal sphincter. Evidence: TAS. Frequency: Occasional (HP:0040283). (ORPHA:7)
- Anal atresia (HP:0002023): Congenital absence of the anus, i.e., the opening at the bottom end of the intestinal tract. Evidence: TAS. Frequency: Occasional (HP:0040283). (ORPHA:7)
- Ventriculomegaly (HP:0002119): An increase in size of the ventricular system of the brain. Evidence: TAS. Frequency: Frequent (HP:0040282). (ORPHA:7)
- Abnormal speech pattern (HP:0002167): An abnormality in the sound (volume) or cadence (rate) of speech. Evidence: TAS. Frequency: Very frequent (HP:0040281). (ORPHA:7)
- Recurrent respiratory infections (HP:0002205): An increased susceptibility to respiratory infections as manifested by a history of recurrent respiratory infections. Evidence: TAS. Frequency: Frequent (HP:0040282). (ORPHA:7)
- Abnormality of neuronal migration (HP:0002269): An abnormality resulting from an anomaly of neuronal migration, i.e., of the process by which neurons travel from their origin to their final position in the brain. Evidence: TAS. Frequency: Occasional (HP:0040283). (ORPHA:7)
- Intestinal malrotation (HP:0002566): An abnormality of the intestinal rotation and fixation that normally occurs during the development of the gut. This can lead to volvulus, or twisting of the intestine that causes obstruction and necrosis. Evidence: TAS. Frequency: Occasional (HP:0040283). (ORPHA:7)
- Scoliosis (HP:0002650): The presence of an abnormal lateral curvature of the spine. Evidence: TAS. Frequency: Frequent (HP:0040282). (ORPHA:7)
- High, narrow palate (HP:0002705): The presence of a high and narrow palate. Evidence: TAS. Frequency: Frequent (HP:0040282). (ORPHA:7)
- Kyphosis (HP:0002808): Exaggerated anterior convexity of the thoracic vertebral column. Evidence: TAS. Frequency: Frequent (HP:0040282). (ORPHA:7)
- Hemivertebrae (HP:0002937): Absence of one half of the vertebral body. Evidence: TAS. Frequency: Occasional (HP:0040283). (ORPHA:7)
- Short nose (HP:0003196): Distance from nasion to subnasale more than two standard deviations below the mean, or alternatively, an apparently decreased length from the nasal root to the nasal tip. Evidence: TAS. Frequency: Frequent (HP:0040282). (ORPHA:7)
- Abnormal hip bone morphology (HP:0003272): An abnormality of the hip bone. Evidence: TAS. Frequency: Occasional (HP:0040283). (ORPHA:7)
- Short stature (HP:0004322): A height below that which is expected according to age and gender norms. Although there is no universally accepted definition of short stature, many refer to "short stature" as height more than 2 standard deviations below the mean for age and gender (or below the 3rd percentile for age and gender dependent norms). Evidence: TAS. Frequency: Frequent (HP:0040282). (ORPHA:7)
- Hypoplastic left ventricle (HP:0004383): A severe congenital heart defect characterized by underdevelopment of the left ventricle. Evidence: TAS. Frequency: Frequent (HP:0040282). (ORPHA:7)
- Ectopic anus (HP:0004397): Abnormal displacement or malposition of the anus. Evidence: TAS. Frequency: Occasional (HP:0040283). (ORPHA:7)
- Depressed nasal bridge (HP:0005280): Posterior positioning of the nasal root in relation to the overall facial profile for age. Evidence: TAS. Frequency: Frequent (HP:0040282). (ORPHA:7)
- Finger syndactyly (HP:0006101): Webbing or fusion of the fingers, involving soft parts only or including bone structure. Bony fusions are referred to as "bony" Syndactyly if the fusion occurs in a radio-ulnar axis. Fusions of bones of the fingers in a proximo-distal axis are referred to as "Symphalangism". Evidence: TAS. Frequency: Occasional (HP:0040283). (ORPHA:7)
- Atrioventricular canal defect (HP:0006695): A defect of the atrioventricular septum of the heart. Evidence: TAS. Frequency: Frequent (HP:0040282). (ORPHA:7)
- Aplasia/Hypoplasia of the nipples (HP:0006709). Evidence: TAS. Frequency: Occasional (HP:0040283). (ORPHA:7)
- Aplasia/Hypoplasia of the cerebellum (HP:0007360). Evidence: TAS. Frequency: Frequent (HP:0040282). (ORPHA:7)
- Hypoplasia of penis (HP:0008736). Evidence: TAS. Frequency: Occasional (HP:0040283). (ORPHA:7)
- Feeding difficulties in infancy (HP:0008872): Impaired feeding performance of an infant as manifested by difficulties such as weak and ineffective sucking, brief bursts of sucking, and falling asleep during sucking. There may be difficulties with chewing or maintaining attention. Evidence: TAS. Frequency: Occasional (HP:0040283). (ORPHA:7)
- Postnatal growth retardation (HP:0008897): Slow or limited growth after birth. Evidence: TAS. Frequency: Occasional (HP:0040283). (ORPHA:7)
These phenotypes are associated with the disease 3C syndrome (ORPHA:7).